Phenotypes associated with the disease Spinocerebellar ataxia type 10 (ORPHA:98761):
- Dysarthria (HP:0001260): Dysarthric speech is a general description referring to a neurological speech disorder characterized by poor articulation. Depending on the involved neurological structures, dysarthria may be further classified as spastic, flaccid, ataxic, hyperkinetic and hypokinetic, or mixed. Evidence: TAS. Frequency: Very frequent (HP:0040281). (ORPHA:98761)
- Gait ataxia (HP:0002066): A type of ataxia characterized by the impairment of the ability to coordinate the movements required for normal walking. Gait ataxia is characteirzed by a wide-based staggering gait with a tendency to fall. Evidence: TAS. Frequency: Very frequent (HP:0040281). (ORPHA:98761)
- Progressive cerebellar ataxia (HP:0002073). Evidence: TAS. Frequency: Very frequent (HP:0040281). (ORPHA:98761)
- Nystagmus (HP:0000639): Rhythmic, involuntary oscillations of one or both eyes related to abnormality in fixation, conjugate gaze, or vestibular mechanisms. Evidence: TAS. Frequency: Frequent (HP:0040282). (ORPHA:98761)
- Gaze-evoked nystagmus (HP:0000640): Nystagmus made apparent by looking to the right or to the left. Evidence: TAS. Frequency: Frequent (HP:0040282). (ORPHA:98761)
- Cerebellar atrophy (HP:0001272): Cerebellar atrophy is defined as a cerebellum with initially normal structures, in a posterior fossa with normal size, which displays enlarged fissures (interfolial spaces) in comparison to the foliae secondary to loss of tissue. Cerebellar atrophy implies irreversible loss of tissue and result from an ongoing progressive disease until a final stage is reached or a single injury, e.g. an intoxication or infectious event. Evidence: TAS. Frequency: Frequent (HP:0040282). (ORPHA:98761)
- Dysmetria (HP:0001310): A type of ataxia characterized by the inability to carry out movements with the correct range and motion across the plane of more than one joint related to incorrect estimation of the distances required for targeted movements. Evidence: TAS. Frequency: Frequent (HP:0040282). (ORPHA:98761)
- Dysdiadochokinesis (HP:0002075): A type of ataxia characterized by the impairment of the ability to perform rapidly alternating movements, such as pronating and supinating his or her hand on the dorsum of the other hand as rapidly as possible. Evidence: TAS. Frequency: Frequent (HP:0040282). (ORPHA:98761)
- Intention tremor (HP:0002080): A type of kinetic tremor that occurs during target directed movement is called intention tremor. That is, an oscillatory cerebellar ataxia that tends to be absent when the limbs are inactive and during the first part of voluntary movement but worsening as the movement continues and greater precision is required (e.g., in touching a target such as the patient's nose or a physician's finger). Evidence: TAS. Frequency: Frequent (HP:0040282). (ORPHA:98761)
- Gait imbalance (HP:0002141). Evidence: TAS. Frequency: Frequent (HP:0040282). (ORPHA:98761)
- Scanning speech (HP:0002168): An abnormal pattern of speech in which the words are as if measured or scanned; there is a pause after every syllable, and the syllables themselves are pronounced slowly. Evidence: TAS. Frequency: Frequent (HP:0040282). (ORPHA:98761)
- Generalized-onset seizure (HP:0002197): A generalized-onset seizure is a type of seizure originating at some point within, and rapidly engaging, bilaterally distributed networks. The networks may include cortical and subcortical structures but not necessarily the entire cortex. Evidence: TAS. Frequency: Frequent (HP:0040282). (ORPHA:98761)
- Unsteady gait (HP:0002317). Evidence: TAS. Frequency: Frequent (HP:0040282). (ORPHA:98761)
- Impaired smooth pursuit (HP:0007772): An impairment of the ability to track objects with the ocular smooth pursuit system, a class of rather slow eye movements that minimizes retinal target motion. Evidence: TAS. Frequency: Frequent (HP:0040282). (ORPHA:98761)
- EEG with generalized epileptiform discharges (HP:0011198): EEG discharges recorded on the entire scalp typically seen in persons with epilepsy. Evidence: TAS. Frequency: Frequent (HP:0040282). (ORPHA:98761)
- Kinetic tremor (HP:0030186): Tremor that occurs during any voluntary movement. It may include visually or non-visually guided movements. Tremor during target directed movement is called intention tremor. Evidence: TAS. Frequency: Frequent (HP:0040282). (ORPHA:98761)
- Dyskinesia (HP:0100660): A movement disorder which consists of effects including diminished voluntary movements and the presence of involuntary movements. Evidence: TAS. Frequency: Frequent (HP:0040282). (ORPHA:98761)
- Urinary urgency (HP:0000012): Urge incontinence is the strong, sudden need to urinate. Evidence: TAS. Frequency: Occasional (HP:0040283). (ORPHA:98761)
- Depression (HP:0000716): Frequently experiencing feelings of being down, miserable, and/or hopeless; struggling to recover from these moods; having a pessimistic outlook on the future; feeling a pervasive sense of shame; having a low self-worth; experiencing thoughts of suicide and engaging in suicidal behavior. Evidence: TAS. Frequency: Occasional (HP:0040283). (ORPHA:98761)
- Aggressive behavior (HP:0000718): Behavior or an act aimed at harming a person, animal, or physical property (e.g., acts of physical violence; shouting, swearing, and using harsh language; slashing someone's tires). Evidence: TAS. Frequency: Occasional (HP:0040283). (ORPHA:98761)
- Apathy (HP:0000741): Apathy is a quantitative reduction of interest, motivation and the initiation and persistence of goal-directed behavior, where often the accompanying emotions, thoughts, and social interactions are also diminished. The individual is typically non-reactive to provocations, positive or negative, and appears to not care. Distinguished from lethargy which involves lack of physical or mental energy. Evidence: TAS. Frequency: Occasional (HP:0040283). (ORPHA:98761)
- Hyporeflexia (HP:0001265): Reduction of neurologic reflexes such as the knee-jerk reaction. Evidence: TAS. Frequency: Occasional (HP:0040283). (ORPHA:98761)
- Generalized hypotonia (HP:0001290): Generalized muscular hypotonia (abnormally low muscle tone). Evidence: TAS. Frequency: Occasional (HP:0040283). (ORPHA:98761)
- Hyperreflexia (HP:0001347): Hyperreflexia is the presence of hyperactive stretch reflexes of the muscles. Evidence: TAS. Frequency: Occasional (HP:0040283). (ORPHA:98761)
- Lower limb spasticity (HP:0002061): Spasticity (velocity-dependent increase in tonic stretch reflexes with increased muscle tone and hyperexcitable tendon reflexes) in the muscles of the lower limbs, hips, and pelvis. Evidence: TAS. Frequency: Occasional (HP:0040283). (ORPHA:98761)
- Status epilepticus (HP:0002133): Status epilepticus is a type of prolonged seizure resulting either from the failure of the mechanisms responsible for seizure termination or from the initiation of mechanisms which lead to abnormally prolonged seizures (after time point t1). It is a condition that can have long-term consequences (after time point t2), including neuronal death, neuronal injury, and alteration of neuronal networks, depending on the type and duration of seizures. Evidence: TAS. Frequency: Occasional (HP:0040283). (ORPHA:98761)
- Sleep disturbance (HP:0002360): An abnormal pattern in the quality, quantity, or characteristics of sleep. Evidence: TAS. Frequency: Occasional (HP:0040283). (ORPHA:98761)
- Focal impaired awareness seizure (HP:0002384): Focal impaired awareness seizure (or focal seizure with impaired or lost awareness) is a type of focal-onset seizure characterized by some degree (which may be partial) of impairment of the person's awareness of themselves or their surroundings at any point during the seizure. Evidence: TAS. Frequency: Occasional (HP:0040283). (ORPHA:98761)
- Babinski sign (HP:0003487): Upturning of the big toe (and sometimes fanning of the other toes) in response to stimulation of the sole of the foot. If the Babinski sign is present it can indicate damage to the corticospinal tract. Evidence: TAS. Frequency: Occasional (HP:0040283). (ORPHA:98761)
- Focal motor seizure (HP:0011153): A type of focal-onset seizure characterized by a motor sign as its initial semiological manifestation. Evidence: TAS. Frequency: Occasional (HP:0040283). (ORPHA:98761)